Phenotypes associated with the disease neurodegeneration, childhood-onset, with progressive microcephaly (OMIM:619847):
- Hypertonia (HP:0001276): A condition in which there is increased muscle tone so that arms or legs, for example, are stiff and difficult to move. Evidence: PCS. Frequency: 1/2. (PMID:31271740)
- Narrow forehead (HP:0000341): Width of the forehead or distance between the frontotemporales is more than two standard deviations below the mean (objective); or apparently narrow intertemporal region (subjective). Evidence: PCS. Frequency: 1/2. (PMID:34918187)
- Congenital onset (HP:0003577): A phenotypic abnormality that is present at birth. Evidence: PCS. Frequency: 2/2. (PMID:31271740)
- Clonus (HP:0002169): A series of rhythmic and involuntary muscle contractions (at a frequency of about 5 to 7 Hz) that occur in response to an abruptly applied and sustained stretch. Evidence: PCS. Frequency: 1/2. (PMID:34918187)
- Short stature (HP:0004322): A height below that which is expected according to age and gender norms. Although there is no universally accepted definition of short stature, many refer to "short stature" as height more than 2 standard deviations below the mean for age and gender (or below the 3rd percentile for age and gender dependent norms). Evidence: PCS. Frequency: 1/2. (PMID:34918187)
- Seizure (HP:0001250): A seizure is an intermittent abnormality of nervous system physiology characterized by a transient occurrence of signs and/or symptoms due to abnormal excessive or synchronous neuronal activity in the brain. Evidence: PCS. Frequency: 1/2. (PMID:31271740)
- Hypotonia (HP:0001252): Hypotonia is an abnormally low muscle tone (the amount of tension or resistance to movement in a muscle). Even when relaxed, muscles have a continuous and passive partial contraction which provides some resistance to passive stretching. Hypotonia thus manifests as diminished resistance to passive stretching. Hypotonia is not the same as muscle weakness, although the two conditions can co-exist. Evidence: PCS. Frequency: 2/2. (PMID:31271740)
- Infantile onset (HP:0003593): Onset of signs or symptoms of disease between 28 days to one year of life. Evidence: PCS. Frequency: 2/2. (PMID:34918187)
- Widened subarachnoid space (HP:0012704): An increase in size of the anatomic space between the arachnoid membrane and pia mater. Evidence: PCS. Frequency: 2/2. (PMID:34918187)
- Cerebral visual impairment (HP:0100704): A form of loss of vision caused by damage to the visual cortex rather than a defect in the eye. Evidence: PCS. Frequency: 1/2. (PMID:31271740)
- Respiratory failure (HP:0002878): A severe form of respiratory insufficiency characterized by inadequate gas exchange such that the levels of oxygen or carbon dioxide cannot be maintained within normal limits. Evidence: PCS. Frequency: 1/2. (PMID:31271740)
- Laryngomalacia (HP:0001601): Laryngomalacia is a congenital abnormality of the laryngeal cartilage in which the cartilage is floppy and prolapses over the larynx during inspiration. Evidence: PCS. Frequency: 1/2. (PMID:31271740)
- Breech presentation (HP:0001623): A position of the fetus at delivery in which the fetus enters the birth canal with the buttocks or feet first. Evidence: PCS. Frequency: 1/2. (PMID:31271740)
- Intellectual disability (HP:0001249): The term intellectual disability or intellectual developmental disorder is used to describe significantly sub-average intellectual and adaptive functioning based on clinical assessment and as measured by individually administered, appropriately normed, standardized and validated tests of intellectual functioning and adaptive behavior, with onset during the developmental period from infancy through adolescence. Evidence: PCS. Frequency: 1/1. (PMID:31271740)
- Hyperalaninemia (HP:0003348): An increased concentration of alanine in the blood. Evidence: PCS. Frequency: 1/2. (PMID:31271740)
- Hyperreflexia (HP:0001347): Hyperreflexia is the presence of hyperactive stretch reflexes of the muscles. Evidence: PCS. Frequency: 1/2. (PMID:34918187)
- Opisthotonus (HP:0002179): Opisthotonus is defined as a dramatic abnormal posture due to spastic contraction of the extensor muscles of the neck, trunk, and lower extremities that produces a severe backward arching from neck to heel. In most cases, the trunk is elevated off the ground by a few inches. It is usually sudden in onset and can be sustained or repetitive. It can be considered a variant of decerebrate posturing involving a hyperextension of the neck, back, and limbs. Evidence: PCS. Frequency: 1/2. (PMID:34918187)
- Spastic tetraplegia (HP:0002510): Spastic paralysis affecting all four limbs. Evidence: PCS. Frequency: 1/2. (PMID:31271740)
- Dysphagia (HP:0002015): Difficulty in swallowing. Evidence: PCS. Frequency: 1/2. (PMID:31271740)
- Cerebral atrophy (HP:0002059): Atrophy (wasting, decrease in size of cells or tissue) affecting the cerebrum. Evidence: PCS. Frequency: 3/4. (PMID:34918187;PMID:31271740)
- Polyhydramnios (HP:0001561): The presence of excess amniotic fluid in the uterus during pregnancy. Evidence: PCS. Frequency: 1/2. (PMID:34918187)
- Lateral ventricle dilatation (HP:0006956). Evidence: PCS. Frequency: 1/2. (PMID:34918187)
- Micropenis (HP:0000054): Abnormally small penis. At birth, the normal penis is about 3 cm (stretched length from pubic tubercle to tip of penis) with micropenis less than 2.0-2.5 cm. Evidence: PCS. Frequency: 1/2. (PMID:34918187)
- Microcephaly (HP:0000252): Head circumference below 2 standard deviations below the mean for age and gender. Evidence: PCS. Frequency: 1/2. (PMID:34918187)
- Status epilepticus (HP:0002133): Status epilepticus is a type of prolonged seizure resulting either from the failure of the mechanisms responsible for seizure termination or from the initiation of mechanisms which lead to abnormally prolonged seizures (after time point t1). It is a condition that can have long-term consequences (after time point t2), including neuronal death, neuronal injury, and alteration of neuronal networks, depending on the type and duration of seizures. Evidence: PCS. Frequency: 1/2. (PMID:31271740)
- Developmental regression (HP:0002376): Loss of developmental skills, as manifested by loss of developmental milestones. Evidence: PCS. Frequency: 1/2. (PMID:31271740)
- Babinski sign (HP:0003487): Upturning of the big toe (and sometimes fanning of the other toes) in response to stimulation of the sole of the foot. If the Babinski sign is present it can indicate damage to the corticospinal tract. Evidence: PCS. Frequency: 1/2. (PMID:34918187)
- Full cheeks (HP:0000293): Increased prominence or roundness of soft tissues between zygomata and mandible. Evidence: PCS. Frequency: 1/2. (PMID:34918187)
- Feeding difficulties (HP:0011968): Impaired ability to eat related to problems gathering food and getting ready to suck, chew, or swallow it. Evidence: PCS. Frequency: 1/2. (PMID:34918187)
- Febrile seizure (within the age range of 3 months to 6 years) (HP:0002373): A febrile seizure is any type of seizure (most often a generalized tonic-clonic seizure) occurring with fever (at least 38 degrees Celsius) but in the absence of central nervous system infection, severe metabolic disturbance or other alternative precipitant in children between the ages of 3 months and 6 years. Evidence: PCS. Frequency: 1/2. (PMID:34918187)
- Limb dystonia (HP:0002451): A type of dystonia (abnormally increased muscular tone causing fixed abnormal postures) that affects muscles of the limbs. Evidence: PCS. Frequency: 1/2. (PMID:31271740)
- Increased circulating lactate concentration (HP:0002151): Abnormally increased level of blood lactate (2-hydroxypropanoic acid). Lactate is produced from pyruvate by lactate dehydrogenase during normal metabolism. The terms lactate and lactic acid are often used interchangeably but lactate (the component measured in blood) is strictly a weak base whereas lactic acid is the corresponding acid. Lactic acidosis is often used clinically to describe elevated lactate but should be reserved for cases where there is a corresponding acidosis (pH below 7.35). Evidence: PCS. Frequency: 2/2. (PMID:31271740)
- Global developmental delay (HP:0001263): A delay in the achievement of motor or mental milestones in the domains of development of a child, including motor skills, speech and language, cognitive skills, and social and emotional skills. This term should only be used to describe children younger than five years of age. Evidence: PCS. Frequency: 4/4. (PMID:34918187;PMID:31271740)
- Gliosis (HP:0002171): Gliosis is the focal proliferation of glial cells in the central nervous system. Evidence: PCS. Frequency: 1/2. (PMID:34918187)
- Cerebral palsy (HP:0100021): Cerebral palsy describes a group of permanent disorders of the development of movement and posture, causing activity limitation, that are attributed to nonprogressive disturbances that occurred in the developing fetal or infant brain. The motor disorders of cerebral palsy are often accompanied by disturbances of sensation, perception, cognition, communication, and behavior, by epilepsy, and by secondary musculoskeletal problems. Evidence: PCS. Frequency: 1/2. (PMID:31271740)
- Tube feeding (HP:0033454): Feeding problem necessitating food and nutrient delivery via a tube. Evidence: PCS. Frequency: 1/2. (PMID:31271740)
- Death in childhood (HP:0003819): Death in during childhood, defined here as between the ages of 2 and 10 years. Evidence: PCS. Frequency: 2/2. (PMID:34918187)
- Small for gestational age (HP:0001518): Smaller than normal size according to sex and gestational age related norms, defined as a weight below the 10th percentile for the gestational age. Evidence: PCS. Frequency: 1/2. (PMID:31271740)
- Sensorineural hearing impairment (HP:0000407): A type of hearing impairment in one or both ears related to an abnormal functionality of the cochlear nerve. Evidence: PCS. Frequency: 1/2. (PMID:31271740)
- Primary microcephaly (HP:0011451): Head circumference below 2 standard deviations below the mean for age and gender at birth. Evidence: PCS. Frequency: 2/2. (PMID:31271740)
- Autosomal recessive inheritance (HP:0000007): A mode of inheritance that is observed for traits related to a gene encoded on one of the autosomes (i.e., the human chromosomes 1-22) in which a trait manifests in individuals with two pathogenic alleles, either homozygotes (two copies of the same mutant allele) or compound heterozygotes (whereby each copy of a gene has a distinct mutant allele). Evidence: PCS. (PMID:31271740)
- Spasticity (HP:0001257): A motor disorder characterized by a velocity-dependent increase in tonic stretch reflexes with increased muscle tone, exaggerated (hyperexcitable) tendon reflexes. Evidence: PCS. Frequency: 1/2. (PMID:34918187)
- Cryptorchidism (HP:0000028): Testis in inguinal canal. That is, absence of one or both testes from the scrotum owing to failure of the testis or testes to descend through the inguinal canal to the scrotum. Evidence: PCS. Frequency: 2/4. (PMID:34918187;PMID:31271740)
- Myoclonus (HP:0001336): Very brief, involuntary random muscular contractions occurring at rest, in response to sensory stimuli, or accompanying voluntary movements. Evidence: PCS. Frequency: 1/2. (PMID:34918187)